Phenotypes associated with the disease Monoamine oxidase A deficiency (ORPHA:3057, an Orphanet rare-disease identifier):
- Atypical behavior (HP:0000708, a Human Phenotype Ontology term): Atypical behavior is an abnormality in a person's actions that can be controlled or modulated by the will of the individual. While abnormal behaviors can be difficult to control, they are distinct from other abnormal actions that cannot be affected by the individual's will. Evidence: TAS. Frequency: Very frequent (HP:0040281, a Human Phenotype Ontology term). (ORPHA:3057)
- Cognitive impairment (HP:0100543, a Human Phenotype Ontology term): Abnormal cognition is characterized by deficits in thinking, reasoning, or remembering. Evidence: TAS. Frequency: Very frequent (HP:0040281, a Human Phenotype Ontology term). (ORPHA:3057)